- Cleft palate (HP:0000175): Cleft palate is a developmental defect of the palate resulting from a failure of fusion of the palatine processes and manifesting as a separation of the roof of the mouth (soft and hard palate). Evidence: TAS. Frequency: Very frequent (HP:0040281). (ORPHA:96129)
- Long face (HP:0000276): Facial height (length) is more than 2 standard deviations above the mean (objective); or, an apparent increase in the height (length) of the face (subjective). Evidence: TAS. Frequency: Very frequent (HP:0040281). (ORPHA:96129)
- Short philtrum (HP:0000322): Distance between nasal base and midline upper lip vermilion border more than 2 SD below the mean. Alternatively, an apparently decreased distance between nasal base and midline upper lip vermilion border. Evidence: TAS. Frequency: Very frequent (HP:0040281). (ORPHA:96129)
- Hypoplasia of the maxilla (HP:0000327): Abnormally small dimension of the Maxilla. Usually creating a malocclusion or malalignment between the upper and lower teeth or resulting in a deficient amount of projection of the base of the nose and lower midface region. Evidence: TAS. Frequency: Very frequent (HP:0040281). (ORPHA:96129)
- Conductive hearing impairment (HP:0000405): An abnormality of vibrational conductance of sound to the inner ear leading to impairment of sensory perception of sound. Evidence: TAS. Frequency: Very frequent (HP:0040281). (ORPHA:96129)
- Sensorineural hearing impairment (HP:0000407): A type of hearing impairment in one or both ears related to an abnormal functionality of the cochlear nerve. Evidence: TAS. Frequency: Very frequent (HP:0040281). (ORPHA:96129)
- Thick eyebrow (HP:0000574): Increased density/number and/or increased diameter of eyebrow hairs. Evidence: TAS. Frequency: Very frequent (HP:0040281). (ORPHA:96129)
- Arachnodactyly (HP:0001166): Abnormally long and slender fingers (spider fingers). Evidence: TAS. Frequency: Very frequent (HP:0040281). (ORPHA:96129)
- Intellectual disability (HP:0001249): The term intellectual disability or intellectual developmental disorder is used to describe significantly sub-average intellectual and adaptive functioning based on clinical assessment and as measured by individually administered, appropriately normed, standardized and validated tests of intellectual functioning and adaptive behavior, with onset during the developmental period from infancy through adolescence. Evidence: TAS. Frequency: Very frequent (HP:0040281). (ORPHA:96129)
- Seizure (HP:0001250): A seizure is an intermittent abnormality of nervous system physiology characterized by a transient occurrence of signs and/or symptoms due to abnormal excessive or synchronous neuronal activity in the brain. Evidence: TAS. Frequency: Very frequent (HP:0040281). (ORPHA:96129)
- Hypotonia (HP:0001252): Hypotonia is an abnormally low muscle tone (the amount of tension or resistance to movement in a muscle). Even when relaxed, muscles have a continuous and passive partial contraction which provides some resistance to passive stretching. Hypotonia thus manifests as diminished resistance to passive stretching. Hypotonia is not the same as muscle weakness, although the two conditions can co-exist. Evidence: TAS. Frequency: Very frequent (HP:0040281). (ORPHA:96129)
- Global developmental delay (HP:0001263): A delay in the achievement of motor or mental milestones in the domains of development of a child, including motor skills, speech and language, cognitive skills, and social and emotional skills. This term should only be used to describe children younger than five years of age. Evidence: TAS. Frequency: Very frequent (HP:0040281). (ORPHA:96129)
- Umbilical hernia (HP:0001537): Protrusion of abdominal contents through a defect in the abdominal wall musculature around the umbilicus. Skin and subcutaneous tissue overlie the defect. Evidence: TAS. Frequency: Very frequent (HP:0040281). (ORPHA:96129)
- Alopecia (HP:0001596): A noncongenital process of hair loss, which may progress to partial or complete baldness. Evidence: TAS. Frequency: Very frequent (HP:0040281). (ORPHA:96129)
- Ventricular septal defect (HP:0001629): A hole between the two bottom chambers (ventricles) of the heart. The defect is centered around the most superior aspect of the ventricular septum. Evidence: TAS. Frequency: Very frequent (HP:0040281). (ORPHA:96129)
- Tricuspid valve prolapse (HP:0001704): One or more of the leaflets (cusps) of the tricuspid valve bulges back into the right atrium upon contraction of the right ventricle. Evidence: TAS. Frequency: Very frequent (HP:0040281). (ORPHA:96129)
- Decreased circulating immunoglobulin concentration (HP:0004313): An abnormally decreased level of immunoglobulin in blood. Evidence: TAS. Frequency: Very frequent (HP:0040281). (ORPHA:96129)
- Long toe (HP:0010511): Toes that appear disproportionately long compared to the foot. Evidence: TAS. Frequency: Very frequent (HP:0040281). (ORPHA:96129)
- Keloids (HP:0010562). Evidence: TAS. Frequency: Very frequent (HP:0040281). (ORPHA:96129)
- Pulmonary valve atresia (HP:0010882): A congenital disorder of the pulmonary valve in which the orifice of the valve fails to develop. Evidence: TAS. Frequency: Very frequent (HP:0040281). (ORPHA:96129)
- Pelvic organ prolapse (HP:0031607): Pelvic organ prolapse (POP) refers to the protrusion of one or more female pelvic organs outside the pelvis through the vagina including uterus, bladder and intestines, and causes the pelvic organs to drop downward to the vaginal wall. That is, POP is defined as the anatomical prolapse with descent of at least one of the vaginal walls to or beyond the vaginal hymen with maximal Valsalva effort with the presence either of bothersome characteristic symptoms, most commonly the sensation of vaginal bulge, or of functional or medical compromise due to prolapse without symptom bother. Evidence: TAS. Frequency: Very frequent (HP:0040281). (ORPHA:96129)
- Joint hypermobility (HP:0001382): The capability that a joint (or a group of joints) has to move, passively and/or actively, beyond normal limits along physiological axes. Evidence: TAS. Frequency: Very frequent (HP:0040281). (ORPHA:96129)
- Posteriorly rotated ears (HP:0000358): A type of abnormal location of the ears in which the position of the ears is characterized by posterior rotation (the superior part of the ears is rotated towards the back of the head, and the inferior part of the ears towards the front). Evidence: TAS. Frequency: Very frequent (HP:0040281). (ORPHA:96129)
These phenotypes are associated with the disease Distal deletion 19p syndrome (ORPHA:96129).